Phenotypes associated with the disease testicular germ cell tumor 1 (OMIM:300228):
- Germ cell neoplasia (HP:0100728). Evidence: IEA. (OMIM:300228)
- X-linked inheritance (HP:0001417): A mode of inheritance that is observed for traits related to a gene encoded on the X chromosome. Evidence: IEA. (OMIM:300228)